Phenotypes associated with the disease focal segmental glomerulosclerosis 8 (OMIM:616032):
- Stage 5 chronic kidney disease (HP:0003774): A degree of kidney failure severe enough to require dialysis or kidney transplantation for survival characterized by a severe reduction in glomerular filtration rate (less than 15 ml/min/1.73 m2) and other manifestations including increased serum creatinine. Evidence: PCS. Frequency: 6/6. Onset: Adult onset (HP:0003581). (PMID:24676636)
- Juvenile onset (HP:0003621): Onset of signs or symptoms of disease between the age of 5 and 15 years. Evidence: PCS. Frequency: 1/5. (PMID:24676636)
- Nephrotic syndrome (HP:0000100): Nephrotic syndrome is a collection of findings resulting from glomerular dysfunction with an increase in glomerular capillary wall permeability associated with pronounced proteinuria. Nephrotic syndrome refers to the constellation of clinical findings that result from severe renal loss of protein, with Proteinuria and hypoalbuminemia, edema, and hyperlipidemia. Evidence: PCS. (PMID:24676636)
- Late onset (HP:0003584): A type of adult onset with onset of symptoms after the age of 60 years. Evidence: PCS. Frequency: 1/5. (PMID:24676636)
- Focal segmental glomerulosclerosis (HP:0000097): Segmental accumulation of scar tissue in individual (but not all) glomeruli. Evidence: PCS. Frequency: 9/9. (PMID:24676636)
- Young adult onset (HP:0011462): Onset of disease at the age of between 16 and 40 years. Evidence: PCS. Frequency: 3/5. (PMID:24676636)
- Proteinuria (HP:0000093): Increased levels of protein in the urine. Evidence: PCS. Frequency: 5/5. (PMID:24676636)
- Autosomal dominant inheritance (HP:0000006): A mode of inheritance that is observed for traits related to a gene encoded on one of the autosomes (i.e., the human chromosomes 1-22) in which a trait manifests in heterozygotes. In the context of medical genetics, an autosomal dominant disorder is caused when a single copy of the mutant allele is present. Males and females are affected equally, and can both transmit the disorder with a risk of 50% for each child of inheriting the mutant allele. Evidence: PCS. (PMID:24676636)